Phenotypes associated with the disease atrichia with papular lesions (OMIM:209500):
- Generalized papillary lesions (HP:0007482). Evidence: IEA. (OMIM:209500)
- Autosomal recessive inheritance (HP:0000007): A mode of inheritance that is observed for traits related to a gene encoded on one of the autosomes (i.e., the human chromosomes 1-22) in which a trait manifests in individuals with two pathogenic alleles, either homozygotes (two copies of the same mutant allele) or compound heterozygotes (whereby each copy of a gene has a distinct mutant allele). Evidence: IEA. (OMIM:209500)
- Sparse hair (HP:0008070): Reduced density of hairs. Evidence: IEA. (OMIM:209500)